- Dystonia (HP:0001332): An abnormally increased muscular tone that causes fixed abnormal postures. There is a slow, intermittent twisting motion that leads to exaggerated turning and posture of the extremities and trunk. Evidence: TAS. Frequency: Very frequent (HP:0040281). (ORPHA:98809)
- Chorea (HP:0002072): Chorea (Greek for 'dance') refers to widespread arrhythmic involuntary movements of a forcible, jerky and restless fashion. It is a random-appearing sequence of one or more discrete involuntary movements or movement fragments. Movements appear random because of variability in timing, duration or location. Each movement may have a distinct start and end. However, movements may be strung together and thus may appear to flow randomly from one muscle group to another. Chorea can involve the trunk, neck, face, tongue, and extremities. Evidence: TAS. Frequency: Very frequent (HP:0040281). (ORPHA:98809)
- Athetosis (HP:0002305): A slow, continuous, involuntary writhing movement that prevents maintenance of a stable posture. Athetosis involves continuous smooth movements that appear random and are not composed of recognizable sub-movements or movement fragments. In contrast to chorea, in athetosis, the same regions of the body are repeatedly involved. Athetosis may worsen with attempts at movement of posture, but athetosis can also occur at rest. Evidence: TAS. Frequency: Very frequent (HP:0040281). (ORPHA:98809)
- Involuntary movements (HP:0004305): Involuntary contractions of muscle leading to involuntary movements of extremities, neck, trunk, or face. Evidence: TAS. Frequency: Very frequent (HP:0040281). (ORPHA:98809)
- Dyskinesia (HP:0100660): A movement disorder which consists of effects including diminished voluntary movements and the presence of involuntary movements. Evidence: TAS. Frequency: Very frequent (HP:0040281). (ORPHA:98809)
- Focal sensory seizure (HP:0011157): A focal sensory seizure is a type seizure beginning with a subjective sensation. Evidence: TAS. Frequency: Frequent (HP:0040282). (ORPHA:98809)
- Seizure (HP:0001250): A seizure is an intermittent abnormality of nervous system physiology characterized by a transient occurrence of signs and/or symptoms due to abnormal excessive or synchronous neuronal activity in the brain. Evidence: TAS. Frequency: Occasional (HP:0040283). (ORPHA:98809)
- Migraine (HP:0002076): Migraine is a chronic neurological disorder characterized by episodic attacks of headache and associated symptoms. Evidence: TAS. Frequency: Occasional (HP:0040283). (ORPHA:98809)
- Writer's cramp (HP:0002356): A focal dystonia of the fingers, hand, and/or forearm that appears when the affected person attempts to do a task that requires fine motor movements such as writing or playing a musical instrument. Evidence: TAS. Frequency: Occasional (HP:0040283). (ORPHA:98809)
These phenotypes are associated with the disease Paroxysmal kinesigenic dyskinesia (ORPHA:98809).